- Autosomal dominant inheritance (HP:0000006): A mode of inheritance that is observed for traits related to a gene encoded on one of the autosomes (i.e., the human chromosomes 1-22) in which a trait manifests in heterozygotes. In the context of medical genetics, an autosomal dominant disorder is caused when a single copy of the mutant allele is present. Males and females are affected equally, and can both transmit the disorder with a risk of 50% for each child of inheriting the mutant allele. Evidence: IEA. (OMIM:120450)
- Abnormality of the skin (HP:0000951): An abnormality of the skin. Evidence: IEA. (OMIM:120450)
These phenotypes are associated with the disease comedones, familial Dyskeratotic (OMIM:120450).